Phenotypes associated with the disease combined oxidative phosphorylation deficiency 47 (OMIM:618958):
- Toe syndactyly (HP:0001770): Webbing or fusion of the toes, involving soft parts only or including bone structure. Bony fusions are referred to as "bony" Syndactyly if the fusion occurs in a radio-ulnar axis. Fusions of bones of the toes in a proximo-distal axis are referred to as "Symphalangism". Evidence: PCS. Frequency: 1/1. (PMID:30566640)
- Long philtrum (HP:0000343): Distance between nasal base and midline upper lip vermilion border more than 2 SD above the mean. Alternatively, an apparently increased distance between nasal base and midline upper lip vermilion border. Evidence: PCS. Frequency: 1/1. (PMID:30566640)
- Hepatomegaly (HP:0002240): Abnormally increased size of the liver. Evidence: PCS. Frequency: 1/1. (PMID:30566640)
- Generalized hypotonia (HP:0001290): Generalized muscular hypotonia (abnormally low muscle tone). Evidence: PCS. Frequency: 1/1. (PMID:30566640)
- Cone-shaped epiphyses of the distal phalanges of the hand (HP:0010248). Evidence: PCS. Frequency: 1/1. (PMID:30566640)
- Cataract (HP:0000518): A cataract is an opacity or clouding that develops in the crystalline lens of the eye or in its capsule. Evidence: PCS. Frequency: 1/1. (PMID:30566640)
- Failure to thrive (HP:0001508): Failure to thrive (FTT) refers to a child whose physical growth is substantially below the norm. Evidence: PCS. Frequency: 1/1. (PMID:30566640)
- Dehydration (HP:0001944). Evidence: PCS. Frequency: 1/1. (PMID:30566640)
- Hypoglycemia (HP:0001943): A decreased concentration of glucose in the blood. Evidence: PCS. Frequency: 1/1. (PMID:30566640)
- Elevated circulating hepatic transaminase concentration (HP:0002910): Elevations of the levels of SGOT and SGPT in the serum. SGOT (serum glutamic oxaloacetic transaminase) and SGPT (serum glutamic pyruvic transaminase) are transaminases primarily found in the liver and heart and are released into the bloodstream as the result of liver or heart damage. SGOT and SGPT are used clinically mainly as markers of liver damage. Evidence: PCS. Frequency: 1/1. (PMID:30566640)
- Round face (HP:0000311): The facial appearance is more circular than usual as viewed from the front. Evidence: PCS. Frequency: 1/1. (PMID:30566640)
- Metabolic acidosis (HP:0001942): Metabolic acidosis (MA) is characterized by a fall in blood pH due to a reduction of serum bicarbonate concentration. This can occur as a result of either the accumulation of acids (high anion gap MA) or the loss of bicarbonate from the gastrointestinal tract or the kidney (hyperchloremic MA). By definition, MA is not due to a respirary cause. Evidence: PCS. Frequency: 1/1. (PMID:30566640)
- Posteriorly rotated ears (HP:0000358): A type of abnormal location of the ears in which the position of the ears is characterized by posterior rotation (the superior part of the ears is rotated towards the back of the head, and the inferior part of the ears towards the front). Evidence: PCS. Frequency: 1/1. (PMID:30566640)
- Dysphagia (HP:0002015): Difficulty in swallowing. Evidence: PCS. Frequency: 1/1. (PMID:30566640)
- Microcephaly (HP:0000252): Head circumference below 2 standard deviations below the mean for age and gender. Evidence: PCS. Frequency: 1/1. (PMID:30566640)
- Short palm (HP:0004279): Short palm. Evidence: PCS. Frequency: 1/1. (PMID:30566640)
- Increased circulating lactate concentration (HP:0002151): Abnormally increased level of blood lactate (2-hydroxypropanoic acid). Lactate is produced from pyruvate by lactate dehydrogenase during normal metabolism. The terms lactate and lactic acid are often used interchangeably but lactate (the component measured in blood) is strictly a weak base whereas lactic acid is the corresponding acid. Lactic acidosis is often used clinically to describe elevated lactate but should be reserved for cases where there is a corresponding acidosis (pH below 7.35). Evidence: PCS. Frequency: 1/1. (PMID:30566640)
- Short neck (HP:0000470): Diminished length of the neck. Evidence: PCS. Frequency: 1/1. (PMID:30566640)
- Sensorineural hearing impairment (HP:0000407): A type of hearing impairment in one or both ears related to an abnormal functionality of the cochlear nerve. Evidence: PCS. Frequency: 1/1. (PMID:30566640)
- Platyspondyly (HP:0000926): A flattened vertebral body shape with reduced distance between the vertebral endplates. Evidence: PCS. Frequency: 1/1. (PMID:30566640)
- Ptosis (HP:0000508): The upper eyelid margin is positioned 3 mm or more lower than usual and covers the superior portion of the iris (objective); or, the upper lid margin obscures at least part of the pupil (subjective). Evidence: PCS. Frequency: 1/1. (PMID:30566640)
- Autosomal recessive inheritance (HP:0000007): A mode of inheritance that is observed for traits related to a gene encoded on one of the autosomes (i.e., the human chromosomes 1-22) in which a trait manifests in individuals with two pathogenic alleles, either homozygotes (two copies of the same mutant allele) or compound heterozygotes (whereby each copy of a gene has a distinct mutant allele). Evidence: PCS. (PMID:30566640)
- Intrauterine growth retardation (HP:0001511): An abnormal restriction of fetal growth with fetal weight below the tenth percentile for gestational age. Evidence: PCS. Frequency: 1/1. (PMID:30566640)
- Cryptorchidism (HP:0000028): Testis in inguinal canal. That is, absence of one or both testes from the scrotum owing to failure of the testis or testes to descend through the inguinal canal to the scrotum. Evidence: PCS. Frequency: 1/1. (PMID:30566640)
- Low-set ears (HP:0000369): Upper insertion of the ear to the scalp below an imaginary horizontal line drawn between the inner canthi of the eye and extending posteriorly to the ear. Evidence: PCS. Frequency: 1/1. (PMID:30566640)